Phenotypes associated with the disease IRVAN syndrome (ORPHA:209943):
- Reduced visual acuity (HP:0007663). Evidence: TAS. Frequency: Frequent (HP:0040282). (ORPHA:209943)
- Ocular hypertension (HP:0007906): Intraocular pressure that is 2 standard deviations above the population mean. Evidence: TAS. Frequency: Frequent (HP:0040282). (ORPHA:209943)
- Vitreous floaters (HP:0100832): Deposits of various size, shape, consistency, refractive index, and motility within the eye's vitreous humor, which is normally transparent. Evidence: TAS. Frequency: Frequent (HP:0040282). (ORPHA:209943)
- Glaucoma (HP:0000501): Glaucoma refers loss of retinal ganglion cells in a characteristic pattern of optic neuropathy usually associated with increased intraocular pressure. Evidence: TAS. Frequency: Occasional (HP:0040283). (ORPHA:209943)
- Retinal detachment (HP:0000541): Separation of the inner layers of the retina (neural retina) from the pigment epithelium. Evidence: TAS. Frequency: Occasional (HP:0040283). (ORPHA:209943)
- Photophobia (HP:0000613): Excessive sensitivity to light with the sensation of discomfort or pain in the eyes due to exposure to bright light. Evidence: TAS. Frequency: Occasional (HP:0040283). (ORPHA:209943)
- Blurred vision (HP:0000622): Lack of sharpness of vision resulting in the inability to see fine detail. Evidence: TAS. Frequency: Occasional (HP:0040283). (ORPHA:209943)
- Optic atrophy (HP:0000648): Atrophy of the optic nerve. Optic atrophy results from the death of the retinal ganglion cell axons that comprise the optic nerve and manifesting as a pale optic nerve on fundoscopy. Evidence: TAS. Frequency: Occasional (HP:0040283). (ORPHA:209943)
- Retinal exudate (HP:0001147): Yellow-white intraretinal deposits in the retina typically associated with damaged inner blood-retina barrier and exudation of serous fluid and lipids from the retinal microvasculature. Evidence: TAS. Frequency: Occasional (HP:0040283). (ORPHA:209943)
- Tractional retinal detachment (HP:0007917): A type of retinal detachment arising due to a combination of contracting retinal membranes, abnormal vitreoretinal adhesions, and vitreous changes, in the absence of a full-thickness retinal defect. Evidence: TAS. Frequency: Occasional (HP:0040283). (ORPHA:209943)
- Macular edema (HP:0040049): Thickening of the retina that takes place due to accumulation of extracellular fluid in the macula as a nonspecific response to blood-retinal barrier breakdown. It can either have a cystoid aspect in the fovea, or a more diffuse aspect. Evidence: TAS. Frequency: Occasional (HP:0040283). (ORPHA:209943)